- Poor wound healing (HP:0001058): A reduced ability to heal cutaneous wounds. Evidence: PCS. Frequency: 2/2. (PMID:23692737)
- Recurrent joint dislocation (HP:0031869): Dislocation of a given joint repeated times. Evidence: PCS. Frequency: 2/2. (PMID:23692737)
- Scoliosis (HP:0002650): The presence of an abnormal lateral curvature of the spine. Evidence: PCS. Frequency: 8/9. (PMID:23692737;PMID:15728585)
- Short stature (HP:0004322): A height below that which is expected according to age and gender norms. Although there is no universally accepted definition of short stature, many refer to "short stature" as height more than 2 standard deviations below the mean for age and gender (or below the 3rd percentile for age and gender dependent norms). Evidence: PCS. Frequency: 11/12. (PMID:23692737;PMID:15728585)
- Dermal translucency (HP:0010648): An abnormally increased ability of the skin to permit light to pass through (translucency) such that subcutaneous structures such as veins display an increased degree of visibility. Evidence: PCS. Frequency: 2/2. (PMID:23692737)
- Inguinal hernia (HP:0000023): Protrusion of the contents of the abdominal cavity through the inguinal canal. Evidence: PCS. Frequency: 1/2. (PMID:23692737)
- Joint hypermobility (HP:0001382): The capability that a joint (or a group of joints) has to move, passively and/or actively, beyond normal limits along physiological axes. Evidence: PCS. Frequency: 17/17. (PMID:17206620;PMID:15728585)
- Blue sclerae (HP:0000592): An abnormal bluish coloration of the sclera. Evidence: PCS. Frequency: 12/12. (PMID:23692737;PMID:17206620;PMID:15728585)
- Generalized hypotonia (HP:0001290): Generalized muscular hypotonia (abnormally low muscle tone). Evidence: PCS. Frequency: 2/2. (PMID:23692737)
- Childhood onset (HP:0011463): Onset of disease at the age of between 1 and 5 years. Evidence: PCS. Frequency: 2/2. (PMID:23692737)
- Arterial rupture (HP:0025019): Sudden breakage of an artery leading to leakage of blood from the circulation. Evidence: PCS. Frequency: 1/2. (PMID:23692737)
- Bruising susceptibility (HP:0000978): An ecchymosis (bruise) refers to the skin discoloration caused by the escape of blood into the tissues from ruptured blood vessels. This term refers to an abnormally increased susceptibility to bruising. The corresponding phenotypic abnormality is generally elicited on medical history as a report of frequent ecchymoses or bruising without adequate trauma. Evidence: PCS. Frequency: 2/2. (PMID:23692737)
- Recurrent fractures (HP:0002757): The repeated occurrence of bone fractures (implying an abnormally increased tendency for fracture). Evidence: PCS. Frequency: 12/12. (PMID:23692737;PMID:17206620;PMID:15728585)
- Atrial septal defect (HP:0001631): Atrial septal defect (ASD) is a congenital abnormality of the interatrial septum that enables blood flow between the left and right atria via the interatrial septum. Evidence: PCS. Frequency: 1/2. (PMID:23692737)
- Hyperextensible skin (HP:0000974): A condition in which the skin can be stretched beyond normal, and then returns to its initial position. Evidence: PCS. Frequency: 2/2. (PMID:23692737)
- Reduced bone mineral density (HP:0004349): A reduction of bone mineral density, that is, of the amount of matter per cubic centimeter of bones. Evidence: PCS. Frequency: 7/7. (PMID:17206620;PMID:15728585)
- Autosomal dominant inheritance (HP:0000006): A mode of inheritance that is observed for traits related to a gene encoded on one of the autosomes (i.e., the human chromosomes 1-22) in which a trait manifests in heterozygotes. In the context of medical genetics, an autosomal dominant disorder is caused when a single copy of the mutant allele is present. Males and females are affected equally, and can both transmit the disorder with a risk of 50% for each child of inheriting the mutant allele. Evidence: PCS. (PMID:15728585)
These phenotypes are associated with the disease combined osteogenesis imperfecta and Ehlers-Danlos syndrome 1 (OMIM:619115).